Phenotypes associated with the disease Medial condensing osteitis of the clavicle (ORPHA:57196):
- Abnormal clavicle morphology (HP:0000889): Any abnormality of the clavicles (collar bones). Evidence: TAS. Frequency: Frequent (HP:0040282). (ORPHA:57196)
- Patchy reduction of bone mineral density (HP:0010657): Patchy (irregular) reduction in bone density. This can take on many forms depending on severity and distribution as can be seen on x-rays. Evidence: TAS. Frequency: Frequent (HP:0040282). (ORPHA:57196)
- Shoulder pain (HP:0030834): An unpleasant sensation characterized by physical discomfort (such as pricking, throbbing, or aching) localized to the shoulder. Evidence: TAS. Frequency: Frequent (HP:0040282). (ORPHA:57196)
- Limited shoulder movement (HP:0006467): A limitation of the range of movement of the shoulder joint. Evidence: TAS. Frequency: Occasional (HP:0040283). (ORPHA:57196)
- Elevated circulating C-reactive protein concentration (HP:0011227): The concentration of C-reactive protein in the blood circulation is above the upper limit of normal. Evidence: TAS. Frequency: Occasional (HP:0040283). (ORPHA:57196)